Phenotypes associated with the disease Global developmental delay-visual anomalies-progressive cerebellar atrophy-truncal hypotonia syndrome (ORPHA:480898):
- Retrognathia (HP:0000278): An abnormality in which the mandible is mislocalised posteriorly. Evidence: TAS. Frequency: Very frequent (HP:0040281). (ORPHA:480898)
- Deeply set eye (HP:0000490): An eye that is more deeply recessed into the plane of the face than is typical. Evidence: TAS. Frequency: Very frequent (HP:0040281). (ORPHA:480898)
- Delayed speech and language development (HP:0000750): A degree of language development that is significantly below the norm for a child of a specified age. Evidence: TAS. Frequency: Very frequent (HP:0040281). (ORPHA:480898)
- Global developmental delay (HP:0001263): A delay in the achievement of motor or mental milestones in the domains of development of a child, including motor skills, speech and language, cognitive skills, and social and emotional skills. This term should only be used to describe children younger than five years of age. Evidence: TAS. Frequency: Very frequent (HP:0040281). (ORPHA:480898)
- Abnormal facial shape (HP:0001999): An abnormal morphology (form) of the face or its components. Evidence: TAS. Frequency: Very frequent (HP:0040281). (ORPHA:480898)
- Corpus callosum atrophy (HP:0007371): The presence of atrophy (wasting) of the corpus callosum. Evidence: TAS. Frequency: Very frequent (HP:0040281). (ORPHA:480898)
- Diffuse cerebellar atrophy (HP:0100275): Diffuse unlocalised atrophy affecting the cerebellum. Evidence: TAS. Frequency: Very frequent (HP:0040281). (ORPHA:480898)
- Gingival overgrowth (HP:0000212): Hyperplasia of the gingiva (that is, a thickening of the soft tissue overlying the alveolar ridge. The degree of thickening ranges from involvement of the interdental papillae alone to gingival overgrowth covering the entire tooth crown. Evidence: TAS. Frequency: Frequent (HP:0040282). (ORPHA:480898)
- Progressive microcephaly (HP:0000253): Progressive microcephaly is diagnosed when the head circumference falls progressively behind age- and gender-dependent norms. Evidence: TAS. Frequency: Frequent (HP:0040282). (ORPHA:480898)
- Short philtrum (HP:0000322): Distance between nasal base and midline upper lip vermilion border more than 2 SD below the mean. Alternatively, an apparently decreased distance between nasal base and midline upper lip vermilion border. Evidence: TAS. Frequency: Frequent (HP:0040282). (ORPHA:480898)
- Abnormality of visual evoked potentials (HP:0000649): An anomaly of visually evoked potentials (VEP), which are electrical potentials, initiated by brief visual stimuli, which are recorded from the scalp overlying the visual cortex. Evidence: TAS. Frequency: Frequent (HP:0040282). (ORPHA:480898)
- Prominent fingertip pads (HP:0001212): A soft tissue prominence of the ventral aspects of the fingertips. The term "persistent fetal fingertip pads" is often used as a synonym, but should better not be used because it implies knowledge of history of the patient which often does not exist. Evidence: TAS. Frequency: Frequent (HP:0040282). (ORPHA:480898)
- Hyporeflexia (HP:0001265): Reduction of neurologic reflexes such as the knee-jerk reaction. Evidence: TAS. Frequency: Frequent (HP:0040282). (ORPHA:480898)
- Cerebral atrophy (HP:0002059): Atrophy (wasting, decrease in size of cells or tissue) affecting the cerebrum. Evidence: TAS. Frequency: Frequent (HP:0040282). (ORPHA:480898)
- Profound intellectual disability (HP:0002187): Profound intellectual disability (ID) is defined as a type of ID characterized by profoundly sub-average adaptive functioning and intellectual functioning, with an intelligence quotient (IQ) below 20. Evidence: TAS. Frequency: Frequent (HP:0040282). (ORPHA:480898)
- Limb hypertonia (HP:0002509). Evidence: TAS. Frequency: Frequent (HP:0040282). (ORPHA:480898)
- Scoliosis (HP:0002650): The presence of an abnormal lateral curvature of the spine. Evidence: TAS. Frequency: Frequent (HP:0040282). (ORPHA:480898)
- Dystonic gait (HP:0031954): Dystonic gait disorders frequently appear bizarre, particularly because activity increases dystonic tonus and posture. The abnormal posture of the foot in dystonic gait typically involves inversion, plantar flexion and tonic extension of the big toe. In many patients complex types of walking, such as walking backwards and running are paradoxically less impaired than walking forward and may seem completely unaffected. Sensory tricks, for instance, if the affected individual rests a hand on his or her neck, may improve or even normalize dystonic gait in some patients. Evidence: TAS. Frequency: Frequent (HP:0040282). (ORPHA:480898)
- Low anterior hairline (HP:0000294): Distance between the hairline (trichion) and the glabella (the most prominent point on the frontal bone above the root of the nose), in the midline, more than two SD below the mean. Alternatively, an apparently decreased distance between the hairline and the glabella. Evidence: TAS. Frequency: Occasional (HP:0040283). (ORPHA:480898)
- Micrognathia (HP:0000347): Developmental hypoplasia of the mandible. Evidence: TAS. Frequency: Occasional (HP:0040283). (ORPHA:480898)
- Abnormal pinna morphology (HP:0000377): An abnormality of the pinna, which is also referred to as the auricle or external ear. Evidence: TAS. Frequency: Occasional (HP:0040283). (ORPHA:480898)
- Astigmatism (HP:0000483): A type of refraction error associated with abnormal curvatures on the anterior and/or posterior surface of the cornea. Evidence: TAS. Frequency: Occasional (HP:0040283). (ORPHA:480898)
- Strabismus (HP:0000486): A misalignment of the eyes so that the visual axes deviate from bifoveal fixation. The classification of strabismus may be based on a number of features including the relative position of the eyes, whether the deviation is latent or manifest, intermittent or constant, concomitant or otherwise and according to the age of onset and the relevance of any associated refractive error. Evidence: TAS. Frequency: Occasional (HP:0040283). (ORPHA:480898)
- Myopia (HP:0000545): An abnormality of refraction characterized by the ability to see objects nearby clearly, while objects in the distance appear blurry. Evidence: TAS. Frequency: Occasional (HP:0040283). (ORPHA:480898)
- Esotropia (HP:0000565): A form of strabismus with one or both eyes turned inward ('crossed') to a relatively severe degree, usually defined as 10 diopters or more. Evidence: TAS. Frequency: Occasional (HP:0040283). (ORPHA:480898)
- Optic atrophy (HP:0000648): Atrophy of the optic nerve. Optic atrophy results from the death of the retinal ganglion cell axons that comprise the optic nerve and manifesting as a pale optic nerve on fundoscopy. Evidence: TAS. Frequency: Occasional (HP:0040283). (ORPHA:480898)
- Vitiligo (HP:0001045). Evidence: TAS. Frequency: Occasional (HP:0040283). (ORPHA:480898)
- Anal atresia (HP:0002023): Congenital absence of the anus, i.e., the opening at the bottom end of the intestinal tract. Evidence: TAS. Frequency: Occasional (HP:0040283). (ORPHA:480898)
- EEG abnormality (HP:0002353): Abnormality observed by electroencephalogram (EEG), which is used to record of the brain's spontaneous electrical activity from multiple electrodes placed on the scalp. Evidence: TAS. Frequency: Occasional (HP:0040283). (ORPHA:480898)
- Laryngotracheomalacia (HP:0008755). Evidence: TAS. Frequency: Occasional (HP:0040283). (ORPHA:480898)
- Cerebral visual impairment (HP:0100704): A form of loss of vision caused by damage to the visual cortex rather than a defect in the eye. Evidence: TAS. Frequency: Occasional (HP:0040283). (ORPHA:480898)